Phenotypes associated with the disease nonsyndromic congenital nail disorder 7 (OMIM:605779):
- Nail dysplasia (HP:0002164): The presence of developmental dysplasia of the nail. Evidence: TAS. (OMIM:605779)
- Platonychia (HP:0030803): Abnormal flat nail. Evidence: TAS. (OMIM:605779)
- Concave nail (HP:0001598): The natural longitudinal (posterodistal) convex arch is not present or is inverted. Evidence: TAS. (OMIM:605779)
- Autosomal dominant inheritance (HP:0000006): A mode of inheritance that is observed for traits related to a gene encoded on one of the autosomes (i.e., the human chromosomes 1-22) in which a trait manifests in heterozygotes. In the context of medical genetics, an autosomal dominant disorder is caused when a single copy of the mutant allele is present. Males and females are affected equally, and can both transmit the disorder with a risk of 50% for each child of inheriting the mutant allele. Evidence: IEA. (OMIM:605779)